Phenotypes associated with the disease autoimmune disease, multisystem, infantile-onset, 5 (OMIM:621235):
- Mild intellectual disability (HP:0001256): Mild intellectual disability (ID) is defined as a type of ID characterized by mildly sub-average adaptive functioning and intellectual functioning, with an intelligence quotient (IQ) the range of 50-69. Evidence: PCS. Frequency: 1/2. (PMID:38634869)
- Interictal EEG abnormality (HP:0025373): Interictal refers to a period of time between epileptic seizures. Electroencephalographic (EEG) patterns are important in the differential diagnosis of epilepsy, and the EEG is almost always abnormal during a seizure. Some persons with seizures may show EEG abnormalities between seizures, while others do not. In some cases, multiple interictal EEGs must be recorded before an abnormality is observed. In most cases the electrographic pattern of seizure onset is completely different from the activity recorded during interictal discharge. Evidence: PCS. Frequency: 1/2. (PMID:38634869)
- Delayed speech and language development (HP:0000750): A degree of language development that is significantly below the norm for a child of a specified age. Evidence: PCS. Frequency: 1/2. (PMID:38634869)
- Anti-thyroid peroxidase antibody positivity (HP:0025379): The presence of autoantibodies (immunoglobulins) in the serum that react against thyroid peroxidase. Evidence: PCS. Frequency: 1/1. (PMID:38634869)
- Seizure (HP:0001250): A seizure is an intermittent abnormality of nervous system physiology characterized by a transient occurrence of signs and/or symptoms due to abnormal excessive or synchronous neuronal activity in the brain. Evidence: PCS. Frequency: 1/2. (PMID:38634869)
- Decreased circulating C-peptide concentration (HP:0030795): The concentration of C-peptide in the blood circulation is below the lower limit of normal. Evidence: PCS. Frequency: 2/2. (PMID:38634869)
- Asthma (HP:0002099): Asthma is characterized by increased responsiveness of the tracheobronchial tree to multiple stimuli, leading to narrowing of the air passages with resultant dyspnea, cough, and wheezing. Evidence: PCS. Frequency: 1/2. (PMID:38634869)
- Infantile onset (HP:0003593): Onset of signs or symptoms of disease between 28 days to one year of life. Evidence: PCS. Frequency: 1/2. (PMID:38634869)
- Reduced circulating growth hormone concentration (HP:0034323): Concentration of growth hormone in the blood circulation below normal limits. Evidence: PCS. Frequency: 1/2. (PMID:38634869)
- Type I diabetes mellitus (HP:0100651): A chronic condition in which the pancreas produces little or no insulin. Type I diabetes mellitus is manifested by the sudden onset of severe hyperglycemia with rapid progression to diabetic ketoacidosis unless treated with insulin. Evidence: PCS. Frequency: 2/2. (PMID:38634869)
- Unusual bronchiolitis (HP:0011950): Increased susceptibility to bronchiolitis (inflammation of the bronchioles) as manifested by recurrent or severe epsiodes of bronchiolitis. Evidence: PCS. Frequency: 1/2. (PMID:38634869)
- Anti-islet antigen-2 antibody positivity (HP:0034063): The presence of autoantibodies (immunoglobulins) in the serum that react against tyrosine phosphatase IA-2. Evidence: PCS. Frequency: 0/2. (PMID:38634869)
- Hypothyroidism (HP:0000821): Deficiency of thyroid hormone. Evidence: PCS. Frequency: 1/2. (PMID:38634869)
- Autosomal recessive inheritance (HP:0000007): A mode of inheritance that is observed for traits related to a gene encoded on one of the autosomes (i.e., the human chromosomes 1-22) in which a trait manifests in individuals with two pathogenic alleles, either homozygotes (two copies of the same mutant allele) or compound heterozygotes (whereby each copy of a gene has a distinct mutant allele). Evidence: PCS. (PMID:38634869)
- Anti-glutamic acid decarboxylase antibody positivity (HP:0025329): The presence of autoantibodies (immunoglobulins) in the serum that react against glutamic acid decarboxylase. Evidence: PCS. Frequency: 0/2. (PMID:38634869)
- Neonatal onset (HP:0003623): Onset of signs or symptoms of disease within the first 28 days of life. Evidence: PCS. Frequency: 1/2. (PMID:38634869)